Phenotypes associated with the disease porokeratosis 7, multiple types (OMIM:614714):
- Parakeratosis (HP:0001036): Abnormal formation of the keratinocytes of the epidermis characterized by persistence of nuclei, incomplete formation of keratin, and moistness and swelling of the keratinocytes. Evidence: PCS. (PMID:22983302)
- Porokeratosis (HP:0200044): A clonal disorder of keratinization with one or multiple atrophic patches surrounded by a clinically and histologically distinctive hyperkeratotic ridgelike border called the cornoid lamella. Evidence: PCS. (PMID:22983302)
- Autosomal dominant inheritance (HP:0000006): A mode of inheritance that is observed for traits related to a gene encoded on one of the autosomes (i.e., the human chromosomes 1-22) in which a trait manifests in heterozygotes. In the context of medical genetics, an autosomal dominant disorder is caused when a single copy of the mutant allele is present. Males and females are affected equally, and can both transmit the disorder with a risk of 50% for each child of inheriting the mutant allele. Evidence: PCS. (PMID:22983302)